Phenotypes associated with the disease dissecting cellulitis of the scalp (OMIM:260910):
- Alopecia (HP:0001596): A noncongenital process of hair loss, which may progress to partial or complete baldness. Evidence: IEA. (OMIM:260910)
- Perifolliculitis (HP:0012322): Inflammation surrounding hair follicles. Evidence: IEA. (OMIM:260910)
- Alopecia of scalp (HP:0002293). Evidence: IEA. (OMIM:260910)
- Sporadic (HP:0003745): Cases of the disease in question occur without a previous family history, i.e., as isolated cases without being transmitted from a parent and without other siblings being affected. Evidence: TAS. (OMIM:260910)